- Myopia (HP:0000545): An abnormality of refraction characterized by the ability to see objects nearby clearly, while objects in the distance appear blurry. Evidence: TAS. (OMIM:609259)
This phenotype is associated with the disease myopia 10 (OMIM:609259).